Phenotypes associated with the disease Kabuki syndrome (ORPHA:2322):
- Ptosis (HP:0000508): The upper eyelid margin is positioned 3 mm or more lower than usual and covers the superior portion of the iris (objective); or, the upper lid margin obscures at least part of the pupil (subjective). Evidence: TAS. Frequency: Frequent (HP:0040282). (ORPHA:2322)
- Long palpebral fissure (HP:0000637): Distance between medial and lateral canthi is more than two standard deviations above the mean for age (objective); or, apparently increased length of the palpebral fissures. Evidence: TAS. Frequency: Frequent (HP:0040282). (ORPHA:2322)
- Peters anomaly (HP:0000659): A form of anterior segment dysgenesis in which abnormal cleavage of the anterior chamber occurs. Peters anomaly is characterized by central, paracentral, or complete corneal opacity. Evidence: TAS. Frequency: Frequent (HP:0040282). (ORPHA:2322)
- Hypodontia (HP:0000668): The absence of five or less teeth from the normal series by a failure to develop. Evidence: TAS. Frequency: Frequent (HP:0040282). (ORPHA:2322)
- Widely spaced teeth (HP:0000687): Increased spaces (diastemata) between most of the teeth in the same dental arch. Evidence: TAS. Frequency: Frequent (HP:0040282). (ORPHA:2322)
- Microdontia (HP:0000691): Decreased size of the teeth, which can be defined as a mesiodistal tooth diameter (width) more than 2 SD below mean. Alternatively, an apparently decreased maximum width of tooth. Evidence: TAS. Frequency: Frequent (HP:0040282). (ORPHA:2322)
- Prominent fingertip pads (HP:0001212): A soft tissue prominence of the ventral aspects of the fingertips. The term "persistent fetal fingertip pads" is often used as a synonym, but should better not be used because it implies knowledge of history of the patient which often does not exist. Evidence: TAS. Frequency: Frequent (HP:0040282). (ORPHA:2322)
- Hypotonia (HP:0001252): Hypotonia is an abnormally low muscle tone (the amount of tension or resistance to movement in a muscle). Even when relaxed, muscles have a continuous and passive partial contraction which provides some resistance to passive stretching. Hypotonia thus manifests as diminished resistance to passive stretching. Hypotonia is not the same as muscle weakness, although the two conditions can co-exist. Evidence: TAS. Frequency: Frequent (HP:0040282). (ORPHA:2322)
- Joint dislocation (HP:0001373): Displacement or malalignment of joints. Evidence: TAS. Frequency: Frequent (HP:0040282). (ORPHA:2322)
- Joint hypermobility (HP:0001382): The capability that a joint (or a group of joints) has to move, passively and/or actively, beyond normal limits along physiological axes. Evidence: TAS. Frequency: Frequent (HP:0040282). (ORPHA:2322)
- Failure to thrive (HP:0001508): Failure to thrive (FTT) refers to a child whose physical growth is substantially below the norm. Evidence: TAS. Frequency: Frequent (HP:0040282). (ORPHA:2322)
- Abnormal heart morphology (HP:0001627): Any structural anomaly of the heart. Evidence: TAS. Frequency: Frequent (HP:0040282). (ORPHA:2322)
- Abnormal cardiac septum morphology (HP:0001671): An anomaly of the intra-atrial or intraventricular septum. Evidence: TAS. Frequency: Frequent (HP:0040282). (ORPHA:2322)
- Coarctation of aorta (HP:0001680): Coarctation of the aorta is a narrowing or constriction of a segment of the aorta. Evidence: TAS. Frequency: Frequent (HP:0040282). (ORPHA:2322)
- Ventriculomegaly (HP:0002119): An increase in size of the ventricular system of the brain. Evidence: TAS. Frequency: Frequent (HP:0040282). (ORPHA:2322)
- Cerebral cortical atrophy (HP:0002120): Atrophy of the cortex of the cerebrum. Evidence: TAS. Frequency: Frequent (HP:0040282). (ORPHA:2322)
- Scoliosis (HP:0002650): The presence of an abnormal lateral curvature of the spine. Evidence: TAS. Frequency: Frequent (HP:0040282). (ORPHA:2322)
- Recurrent infections (HP:0002719): Increased susceptibility to infections as manifested by repeated bouts of infection. Evidence: TAS. Frequency: Frequent (HP:0040282). (ORPHA:2322)
- Short stature (HP:0004322): A height below that which is expected according to age and gender norms. Although there is no universally accepted definition of short stature, many refer to "short stature" as height more than 2 standard deviations below the mean for age and gender (or below the 3rd percentile for age and gender dependent norms). Evidence: TAS. Frequency: Frequent (HP:0040282). (ORPHA:2322)
- Abnormal dental morphology (HP:0006482): An abnormality of the morphology of the tooth. Evidence: TAS. Frequency: Frequent (HP:0040282). (ORPHA:2322)
- Floppy infant (HP:0008947): Floppiness/hypotonia is defined as reduced resistance to passive movement of joints. Physical examination of floppy/hypotonic infants shows head lag, lack of shoulder and elbow muscle contraction on traction response, inability to tighten the shoulder girdle muscles (or slipping through) when held under the axillae, scarf sign (when the arm is pulled to the opposite side, the arm wraps around the neck with the elbow crossing midline), hyperdorsiflexion of the feet, easy apposition of the thumb against the forearm, feet touching the cheek with ease and without discomfort, frog leg position, and inverted U sign on ventral suspension (head, arms, and legs hanging down without elbow or knee flexion and the trunk rounded in a dome shape). Evidence: TAS. Frequency: Frequent (HP:0040282). (ORPHA:2322)
- Premature thelarche (HP:0010314): Premature development of the breasts. Evidence: TAS. Frequency: Frequent (HP:0040282). (ORPHA:2322)
- Feeding difficulties (HP:0011968): Impaired ability to eat related to problems gathering food and getting ready to suck, chew, or swallow it. Evidence: TAS. Frequency: Frequent (HP:0040282). (ORPHA:2322)
- Marcus Gunn jaw winking synkinesis (HP:0025186): Unilateral ptosis with associated upper eyelid contraction and contraction of either the external or the internal pterygoid muscle. It is thought to occur because of congenital miswiring of a branch of the fifth cranial nerve into the branch of the third cranial nerve supplying the levator muscle. In Marcus Gunn jaw winking synkinesis, elevation and even retraction of the affected eyelid is triggered by chewing, suction, lateral mandible movement, smiling, sternocleidomastoid contraction, protruding tongue, Valsalva maneuver and even by breathing. Evidence: TAS. Frequency: Frequent (HP:0040282). (ORPHA:2322)
- Absent pubertal growth spurt (HP:0031087): The abrupt and transient increase in the annual growth rate normally observed in adolescent individuals does not occur. Evidence: TAS. Frequency: Frequent (HP:0040282). (ORPHA:2322)
- Cleft lip (HP:0410030): A gap in the lip or lips. Evidence: TAS. Frequency: Frequent (HP:0040282). (ORPHA:2322)
- Cryptorchidism (HP:0000028): Testis in inguinal canal. That is, absence of one or both testes from the scrotum owing to failure of the testis or testes to descend through the inguinal canal to the scrotum. Evidence: TAS. Frequency: Occasional (HP:0040283). (ORPHA:2322)
- Hypospadias (HP:0000047): Abnormal position of urethral meatus on the ventral penile shaft (underside) characterized by displacement of the urethral meatus from the tip of the glans penis to the ventral surface of the penis, scrotum, or perineum. Evidence: TAS. Frequency: Occasional (HP:0040283). (ORPHA:2322)
- Ureteropelvic junction obstruction (HP:0000074): Blockage of urine flow from the renal pelvis to the proximal ureter. Evidence: TAS. Frequency: Occasional (HP:0040283). (ORPHA:2322)
- Duplicated collecting system (HP:0000081): A duplication of the collecting system of the kidney, defined as a kidney with two (instead of, normally, one) pyelocaliceal systems. The pyelocaliceal system is comprised of the renal pelvis and calices. The duplicated renal collecting system can be associated with a single ureter or with double ureters. In the latter case, the two ureters empty separately into the bladder or fuse to form a single ureteral orifice. Evidence: TAS. Frequency: Occasional (HP:0040283). (ORPHA:2322)
- Hydronephrosis (HP:0000126): Severe distention of the kidney with dilation of the renal pelvis and calices. Evidence: TAS. Frequency: Occasional (HP:0040283). (ORPHA:2322)
- Preauricular skin tag (HP:0000384): A rudimentary tag of skin often containing ear tissue including a core of cartilage and located just anterior to the auricle (outer part of the ear). Evidence: TAS. Frequency: Occasional (HP:0040283). (ORPHA:2322)
- Microcornea (HP:0000482): A congenital abnormality of the cornea in which the cornea and the anterior segment of the eye are smaller than normal. The horizontal diameter of the cornea does not reach 10 mm even in adulthood. Evidence: TAS. Frequency: Occasional (HP:0040283). (ORPHA:2322)
- Coloboma (HP:0000589): A developmental defect characterized by a cleft of some portion of the eye or ocular adnexa. Evidence: TAS. Frequency: Occasional (HP:0040283). (ORPHA:2322)
- Blue sclerae (HP:0000592): An abnormal bluish coloration of the sclera. Evidence: TAS. Frequency: Occasional (HP:0040283). (ORPHA:2322)
- Nystagmus (HP:0000639): Rhythmic, involuntary oscillations of one or both eyes related to abnormality in fixation, conjugate gaze, or vestibular mechanisms. Evidence: TAS. Frequency: Occasional (HP:0040283). (ORPHA:2322)
- Autistic behavior (HP:0000729): Persistent deficits in social interaction and communication and interaction as well as a markedly restricted repertoire of activity and interest as well as repetitive patterns of behavior. Evidence: TAS. Frequency: Occasional (HP:0040283). (ORPHA:2322)
- Congenital diaphragmatic hernia (HP:0000776): The presence of a hernia of the diaphragm present at birth. Evidence: TAS. Frequency: Occasional (HP:0040283). (ORPHA:2322)
- Precocious puberty (HP:0000826): The onset of secondary sexual characteristics before a normal age. Although it is difficult to define normal age ranges because of the marked variation with which puberty begins in normal children, precocious puberty can be defined as the onset of puberty before the age of 8 years in girls or 9 years in boys. Evidence: TAS. Frequency: Occasional (HP:0040283). (ORPHA:2322)
- Hypertrichosis (HP:0000998): Hypertrichosis is increased hair growth that is abnormal in quantity or location. Evidence: TAS. Frequency: Occasional (HP:0040283). (ORPHA:2322)
- Brachydactyly (HP:0001156): Digits that appear disproportionately short compared to the hand/foot. The word brachydactyly is used here to describe a series distinct patterns of shortened digits (brachydactyly types A-E). This is the sense used here. Evidence: TAS. Frequency: Occasional (HP:0040283). (ORPHA:2322)
- Seizure (HP:0001250): A seizure is an intermittent abnormality of nervous system physiology characterized by a transient occurrence of signs and/or symptoms due to abnormal excessive or synchronous neuronal activity in the brain. Evidence: TAS. Frequency: Occasional (HP:0040283). (ORPHA:2322)
- Obesity (HP:0001513): Accumulation of substantial excess body fat. Evidence: TAS. Frequency: Occasional (HP:0040283). (ORPHA:2322)
- Atrial septal defect (HP:0001631): Atrial septal defect (ASD) is a congenital abnormality of the interatrial septum that enables blood flow between the left and right atria via the interatrial septum. Evidence: TAS. Frequency: Occasional (HP:0040283). (ORPHA:2322)
- Gastroesophageal reflux (HP:0002020): A condition in which the stomach contents leak backwards from the stomach into the esophagus through the lower esophageal sphincter. Evidence: TAS. Frequency: Occasional (HP:0040283). (ORPHA:2322)
- Abnormality of the outer ear (HP:0000356): An abnormality of the external ear. Evidence: TAS. Frequency: Very frequent (HP:0040281). (ORPHA:2322)
- Macrotia (HP:0000400): Median longitudinal ear length greater than two standard deviations above the mean and median ear width greater than two standard deviations above the mean (objective); or, apparent increase in length and width of the pinna (subjective). Evidence: TAS. Frequency: Very frequent (HP:0040281). (ORPHA:2322)
- Protruding ear (HP:0000411): Angle formed by the plane of the ear and the mastoid bone greater than the 97th centile for age (objective); or, outer edge of the helix more than 2 cm from the mastoid at the point of maximum distance (objective). Evidence: TAS. Frequency: Very frequent (HP:0040281). (ORPHA:2322)
- Long eyelashes (HP:0000527): Mid upper eyelash length >10 mm or increased length of the eyelashes (subjective). Evidence: TAS. Frequency: Very frequent (HP:0040281). (ORPHA:2322)
- Intellectual disability (HP:0001249): The term intellectual disability or intellectual developmental disorder is used to describe significantly sub-average intellectual and adaptive functioning based on clinical assessment and as measured by individually administered, appropriately normed, standardized and validated tests of intellectual functioning and adaptive behavior, with onset during the developmental period from infancy through adolescence. Evidence: TAS. Frequency: Very frequent (HP:0040281). (ORPHA:2322)
- Short columella (HP:0002000): Reduced distance from the anterior border of the naris to the subnasale. Evidence: TAS. Frequency: Very frequent (HP:0040281). (ORPHA:2322)
- Highly arched eyebrow (HP:0002553): Increased height of the central portion of the eyebrow, forming a crescent, semicircular, or inverted U shape. Evidence: TAS. Frequency: Very frequent (HP:0040281). (ORPHA:2322)
- Hemivertebrae (HP:0002937): Absence of one half of the vertebral body. Evidence: TAS. Frequency: Very frequent (HP:0040281). (ORPHA:2322)
- Abnormal vertebral body morphology (HP:0003312): Abnormal form of vertebral body, which is the central cylindrical portion of the vertebra that together with other structures such as the vertebral arch, pedicles, laminae, spinous process, transverse processes, and articular facets makes up a vertebra. Evidence: TAS. Frequency: Very frequent (HP:0040281). (ORPHA:2322)
- Butterfly vertebrae (HP:0003316): A butterfly vertebra (sagittal cleft vertebra or anterior rachischisis) is a sagittal defect in the vertebral body caused by failure of fusion of the two lateral chondrification centers during embryogenesis. The name is based on the appearance of the two hemivertebrae emerging as butterfly wings from the central cleft on x-ray. Evidence: TAS. Frequency: Very frequent (HP:0040281). (ORPHA:2322)
- Sparse lateral eyebrow (HP:0005338): Decreased density/number and/or decreased diameter of lateral eyebrow hairs. Evidence: TAS. Frequency: Very frequent (HP:0040281). (ORPHA:2322)
- Short middle phalanx of finger (HP:0005819): Short (hypoplastic) middle phalanx of finger, affecting one or more fingers. Evidence: TAS. Frequency: Very frequent (HP:0040281). (ORPHA:2322)
- Abnormal dermatoglyphics (HP:0007477): An abnormality of dermatoglyphs (fingerprints), which are present on fingers, palms, toes, and soles. Evidence: TAS. Frequency: Very frequent (HP:0040281). (ORPHA:2322)
- Eversion of lateral third of lower eyelids (HP:0007655). Evidence: TAS. Frequency: Very frequent (HP:0040281). (ORPHA:2322)
- Vertebral clefting (HP:0008428): Schisis (cleft or cleavage) of vertebral bodies. Evidence: TAS. Frequency: Very frequent (HP:0040281). (ORPHA:2322)
- Postnatal growth retardation (HP:0008897): Slow or limited growth after birth. Evidence: TAS. Frequency: Very frequent (HP:0040281). (ORPHA:2322)
- Short 5th finger (HP:0009237): Hypoplasia (congenital reduction in size) of the fifth finger, also known as the little finger. Evidence: TAS. Frequency: Very frequent (HP:0040281). (ORPHA:2322)
- Neurodevelopmental delay (HP:0012758): Neurodevelopmental delay (NDD) refers to delays in the maturation of the brain and central nervous system; infants and young children with NDD may experience delays in the development of one or more skills including gross motor abilities, fine-motor coordination, language abilities and ability to solve increasingly complex problems. Evidence: TAS. Frequency: Very frequent (HP:0040281). (ORPHA:2322)
- Abnormality of the urinary system (HP:0000079): An abnormality of the urinary system. Evidence: TAS. Frequency: Frequent (HP:0040282). (ORPHA:2322)
- Abnormality of the dentition (HP:0000164): Any abnormality of the teeth. Evidence: TAS. Frequency: Frequent (HP:0040282). (ORPHA:2322)
- Cleft palate (HP:0000175): Cleft palate is a developmental defect of the palate resulting from a failure of fusion of the palatine processes and manifesting as a separation of the roof of the mouth (soft and hard palate). Evidence: TAS. Frequency: Frequent (HP:0040282). (ORPHA:2322)
- Orofacial cleft (HP:0000202): The presence of a cleft (gap, opening, or groove) in the oral cavity, including cleft of the upper lip and/or cleft of the palate. Cleft of the upper lip is visible as a groove or fissure in the lip, most frequently due to a congenital failure of the maxillary and median nasal processes to fuse. Cleft palate is characterized by a grooved depression or fissure in the roof of the mouth, most often resulting from a congenital failure of the palate to fuse properly. Clefts of the lip and palate can occur individually or together. It is preferable to code each defect separately. Evidence: TAS. Frequency: Frequent (HP:0040282). (ORPHA:2322)
- High palate (HP:0000218): Height of the palate more than 2 SD above the mean (objective) or palatal height at the level of the first permanent molar more than twice the height of the teeth (subjective). Evidence: TAS. Frequency: Frequent (HP:0040282). (ORPHA:2322)
- Hydrocephalus (HP:0000238): Hydrocephalus is an active distension of the ventricular system of the brain resulting from inadequate passage of CSF from its point of production within the cerebral ventricles to its point of absorption into the systemic circulation. Evidence: TAS. Frequency: Frequent (HP:0040282). (ORPHA:2322)
- Microcephaly (HP:0000252): Head circumference below 2 standard deviations below the mean for age and gender. Evidence: TAS. Frequency: Frequent (HP:0040282). (ORPHA:2322)
- Chronic otitis media (HP:0000389): Chronic otitis media refers to fluid, swelling, or infection of the middle ear that does not heal and may cause permanent damage to the ear. Evidence: TAS. Frequency: Frequent (HP:0040282). (ORPHA:2322)
- Conductive hearing impairment (HP:0000405): An abnormality of vibrational conductance of sound to the inner ear leading to impairment of sensory perception of sound. Evidence: TAS. Frequency: Frequent (HP:0040282). (ORPHA:2322)
- EEG abnormality (HP:0002353): Abnormality observed by electroencephalogram (EEG), which is used to record of the brain's spontaneous electrical activity from multiple electrodes placed on the scalp. Evidence: TAS. Frequency: Occasional (HP:0040283). (ORPHA:2322)
- Decreased circulating IgA concentration (HP:0002720): Decreased levels of immunoglobulin A (IgA). Evidence: TAS. Frequency: Occasional (HP:0040283). (ORPHA:2322)
- Hip dislocation (HP:0002827): Displacement of the femur from its normal location in the hip joint. Evidence: TAS. Frequency: Occasional (HP:0040283). (ORPHA:2322)
- Clinodactyly of the 5th finger (HP:0004209): Clinodactyly refers to a bending or curvature of the fifth finger in the radial direction (i.e., towards the 4th finger). Evidence: TAS. Frequency: Occasional (HP:0040283). (ORPHA:2322)
- Crossed fused renal ectopia (HP:0004736): A developmental anomaly in which the kidneys are fused and localized on the same side of the midline. This anomaly is thought to result from disruption of the normal embryologic migration of the kidneys. Evidence: TAS. Frequency: Occasional (HP:0040283). (ORPHA:2322)
- Renal hypoplasia/aplasia (HP:0008678): Absence or underdevelopment of the kidney. Evidence: TAS. Frequency: Occasional (HP:0040283). (ORPHA:2322)
- Hypoplasia of penis (HP:0008736). Evidence: TAS. Frequency: Occasional (HP:0040283). (ORPHA:2322)
- Lagophthalmos (HP:0030001): A condition in which the eyelids do not close to cover the eye completely. Evidence: TAS. Frequency: Occasional (HP:0040283). (ORPHA:2322)
- Reduced circulating growth hormone concentration (HP:0034323): Concentration of growth hormone in the blood circulation below normal limits. Evidence: TAS. Frequency: Occasional (HP:0040283). (ORPHA:2322)
- Lip pit (HP:0100267): A depression located on a lip. Evidence: TAS. Frequency: Occasional (HP:0040283). (ORPHA:2322)
- Abnormal localization of kidney (HP:0100542): An abnormal site of the kidney. Evidence: TAS. Frequency: Occasional (HP:0040283). (ORPHA:2322)
- Small hand (HP:0200055): Disproportionately small hand. Evidence: TAS. Frequency: Occasional (HP:0040283). (ORPHA:2322)
- Microphthalmia (HP:0000568): A developmental anomaly characterized by abnormal smallness of one or both eyes. Evidence: TAS. Frequency: Very rare (HP:0040284). (ORPHA:2322)
- Optic nerve hypoplasia (HP:0000609): Underdevelopment of the optic nerve. Evidence: TAS. Frequency: Very rare (HP:0040284). (ORPHA:2322)
- Hyperinsulinemic hypoglycemia (HP:0000825): An increased concentration of insulin combined with a decreased concentration of glucose in the blood. Evidence: TAS. Frequency: Very rare (HP:0040284). (ORPHA:2322)
- Anorectal anomaly (HP:0012732): An abnormality of the anus or rectum. Evidence: TAS. Frequency: Very rare (HP:0040284). (ORPHA:2322)
- Pilomatrixoma (HP:0030434): Pilomatricoma is an asymptomatic slowly growing benign cutaneous tumor, differentiating towards the hair matrix of the hair follicle. It is covered by normal or hyperemic skin, and usually varies in size from 0.5 to 3 cm. Evidence: TAS. Frequency: Very rare (HP:0040284). (ORPHA:2322)
- Sensorineural hearing impairment (HP:0000407): A type of hearing impairment in one or both ears related to an abnormal functionality of the cochlear nerve. Evidence: TAS. Frequency: Frequent (HP:0040282). (ORPHA:2322)
- Depressed nasal tip (HP:0000437): Decreased distance from the nasal tip to the nasal base. Evidence: TAS. Frequency: Frequent (HP:0040282). (ORPHA:2322)
- Strabismus (HP:0000486): A misalignment of the eyes so that the visual axes deviate from bifoveal fixation. The classification of strabismus may be based on a number of features including the relative position of the eyes, whether the deviation is latent or manifest, intermittent or constant, concomitant or otherwise and according to the age of onset and the relevance of any associated refractive error. Evidence: TAS. Frequency: Frequent (HP:0040282). (ORPHA:2322)